- Abnormality of the inner ear (HP:0000359): An abnormality of the inner ear. Evidence: TAS. Frequency: Occasional (HP:0040283). (ORPHA:3230)
- Sensorineural hearing impairment (HP:0000407): A type of hearing impairment in one or both ears related to an abnormal functionality of the cochlear nerve. Evidence: TAS. Frequency: Very frequent (HP:0040281). (ORPHA:3230)
- Oligodontia (HP:0000677): The absence of six or more teeth from the normal series by a failure to develop. Evidence: TAS. Frequency: Very frequent (HP:0040281). (ORPHA:3230)
- Vertigo (HP:0002321): An abnormal sensation of spinning while the body is actually stationary. Evidence: TAS. Frequency: Frequent (HP:0040282). (ORPHA:3230)
These phenotypes are associated with the disease Deafness-oligodontia syndrome (ORPHA:3230).